- Abnormal rapid eye movement sleep (HP:0002494, a Human Phenotype Ontology term): Abnormality of REM Sleep are phases of REM sleep are characterized by desynchronized EEG patterns, increases in heart rate and blood pressure, sympathetic activation, and a profound loss of muscle tone except for the eye and middle-ear muscles. There are also phases of rapid eye movements. Evidence: TAS. Frequency: 20/20. (OMIM:609039)
- Sleep attack (HP:0002330, a Human Phenotype Ontology term): A sleep attack is a sudden, irresistable episode of sleep that occurs during waking hours. Evidence: IEA. (OMIM:609039)
- Hypnagogic hallucination (HP:0002519, a Human Phenotype Ontology term): Hypnagogic hallucinations are brief hallucinations that occur when falling asleep. Evidence: IEA. (OMIM:609039)
- Excessive daytime somnolence (HP:0001262, a Human Phenotype Ontology term): A state of abnormally strong desire for sleep during the daytime. Evidence: IEA. (OMIM:609039)
- Cataplexy (HP:0002524, a Human Phenotype Ontology term): A sudden and transient episode of bilateral loss of muscle tone, often triggered by emotions. Evidence: IEA. (OMIM:609039)
- Autosomal dominant inheritance (HP:0000006, a Human Phenotype Ontology term): A mode of inheritance that is observed for traits related to a gene encoded on one of the autosomes (i.e., the human chromosomes 1-22) in which a trait manifests in heterozygotes. In the context of medical genetics, an autosomal dominant disorder is caused when a single copy of the mutant allele is present. Males and females are affected equally, and can both transmit the disorder with a risk of 50% for each child of inheriting the mutant allele. Evidence: IEA. (OMIM:609039)
These phenotypes are associated with the disease narcolepsy 3 (OMIM:609039, an entry in Online Mendelian Inheritance in Man).